Phenotypes associated with the disease impacted teeth, multiple (OMIM:308280):
- Multiple impacted teeth (HP:0001571): The presence of multiple impacted teeth. Evidence: IEA. (OMIM:308280)
- X-linked inheritance (HP:0001417): A mode of inheritance that is observed for traits related to a gene encoded on the X chromosome. Evidence: IEA. (OMIM:308280)
- Supernumerary tooth (HP:0011069): The presence of one or more teeth additional to the normal number. Evidence: IEA. (OMIM:308280)